- Neonatal hyperbilirubinemia (HP:0003265): A type of hyperbilirubinemia with neonatal onset. Evidence: TAS. Frequency: Very frequent (HP:0040281). (ORPHA:79235)
- Prolonged neonatal jaundice (HP:0006579): Neonatal jaundice refers to a yellowing of the skin and other tissues of a newborn infant as a result of increased concentrations of bilirubin in the blood. Neonatal jaundice affects over half of all newborns to some extent in the first week of life. Prolonged neonatal jaundice is said to be present if the jaundice persists for longer than 14 days in term infants and 21 days in preterm infants. Evidence: TAS. Frequency: Very frequent (HP:0040281). (ORPHA:79235)
- Unconjugated hyperbilirubinemia (HP:0008282): An increased amount of unconjugated (indirect) bilurubin in the blood. Evidence: TAS. Frequency: Very frequent (HP:0040281). (ORPHA:79235)
These phenotypes are associated with the disease Crigler-Najjar syndrome type 2 (ORPHA:79235).